Phenotypes associated with the disease Blount disease, infantile (OMIM:188700):
- Abnormality of the proximal tibial epiphysis (HP:0010591): Any abnormality of the proximal epiphysis of the tibia. Evidence: TAS. (OMIM:188700)
- Genu varum (HP:0002970): A positional abnormality marked by outward bowing of the legs in which the knees stay wide apart when a person stands with the feet and ankles together. Evidence: TAS. (OMIM:188700)
- Autosomal dominant inheritance (HP:0000006): A mode of inheritance that is observed for traits related to a gene encoded on one of the autosomes (i.e., the human chromosomes 1-22) in which a trait manifests in heterozygotes. In the context of medical genetics, an autosomal dominant disorder is caused when a single copy of the mutant allele is present. Males and females are affected equally, and can both transmit the disorder with a risk of 50% for each child of inheriting the mutant allele. Evidence: TAS. (OMIM:188700)
- Osteochondritis dissecans (HP:0010886): A joint disorder caused by blood deprivation in the subchondral bone causing the subchondral bone to die in a process called avascular necrosis. The bone is then reabsorbed by the body, leaving the articular cartilage it supported prone to damage. The result is fragmentation (dissection) of both cartilage and bone, and the free movement of these osteochondral fragments within the joint space, causing pain and further damage. Evidence: TAS. (OMIM:188700)